Phenotypes associated with the disease familial hypertryptophanemia (OMIM:600627):
- Moderate intellectual disability (HP:0002342): Moderate intellectual disability (ID) is defined as a type of ID characterized by moderately sub-average adaptive functioning and intellectual functioning, with an intelligence quotient (IQ) the range of 35-49. Evidence: TAS. (OMIM:600627)
- Limited elbow extension (HP:0001377): Limited ability to straighten the arm at the elbow joint. Evidence: IEA. (OMIM:600627)
- Strabismus (HP:0000486): A misalignment of the eyes so that the visual axes deviate from bifoveal fixation. The classification of strabismus may be based on a number of features including the relative position of the eyes, whether the deviation is latent or manifest, intermittent or constant, concomitant or otherwise and according to the age of onset and the relevance of any associated refractive error. Evidence: IEA. (OMIM:600627)
- Generalized joint hypermobility (HP:0002761): Joint hypermobility (ability of a joint to move beyond its normal range of motion) affecting many or all joints of the body. In individuals with Joint hypermobility at multiple sites (usually five or more), the term generalized joint hypermobility is preferred. Evidence: IEA. (OMIM:600627)
- Amplification of sexual behavior (HP:5200321): An abnormal increase of libido (sexual desire), typically accompanied by a higher frequency of sexual activity compared to from a person's previous norm. Evidence: TAS. (OMIM:600627)
- Camptodactyly of finger (HP:0100490): The distal interphalangeal joint and/or the proximal interphalangeal joint of the fingers cannot be extended to 180 degrees by either active or passive extension. Evidence: TAS. (OMIM:600627)
- Stuttering (HP:0025268): Disruptions in the production of speech sounds, with involuntary repetitions of words or parts of words, prolongations of speech sounds, or complete blockage of speech production for several seconds. Evidence: TAS. (OMIM:600627)
- Increased serum serotonin (HP:0003144): A increased concentration of serotonin in the blood. Evidence: PCS. Frequency: 1/1. (PMID:28285122)
- Global developmental delay (HP:0001263): A delay in the achievement of motor or mental milestones in the domains of development of a child, including motor skills, speech and language, cognitive skills, and social and emotional skills. This term should only be used to describe children younger than five years of age. Evidence: PCS. Frequency: 0/1. (PMID:28285122)
- Tryptophanuria (HP:0003361): An increased concentration of tryptophan in the urine. Evidence: TAS. (OMIM:600627)
- Adducted thumb (HP:0001181): In the resting position, the tip of the thumb is on, or near, the palm, close to the base of the fourth or fifth finger. Evidence: TAS. (OMIM:600627)
- Depression (HP:0000716): Frequently experiencing feelings of being down, miserable, and/or hopeless; struggling to recover from these moods; having a pessimistic outlook on the future; feeling a pervasive sense of shame; having a low self-worth; experiencing thoughts of suicide and engaging in suicidal behavior. Evidence: TAS. (OMIM:600627)
- Sensorineural hearing impairment (HP:0000407): A type of hearing impairment in one or both ears related to an abnormal functionality of the cochlear nerve. Evidence: TAS. (OMIM:600627)
- Aggressive behavior (HP:0000718): Behavior or an act aimed at harming a person, animal, or physical property (e.g., acts of physical violence; shouting, swearing, and using harsh language; slashing someone's tires). Evidence: TAS. (OMIM:600627)
- Emotional lability (HP:0000712): Unstable emotional experiences and frequent mood changes; emotions that are easily aroused, intense, and/or disproportionate to events and circumstances. Evidence: IEA. (OMIM:600627)
- Hypertelorism (HP:0000316): Interpupillary distance more than 2 SD above the mean (alternatively, the appearance of an increased interpupillary distance or widely spaced eyes). Evidence: IEA. (OMIM:600627)
- Autosomal recessive inheritance (HP:0000007): A mode of inheritance that is observed for traits related to a gene encoded on one of the autosomes (i.e., the human chromosomes 1-22) in which a trait manifests in individuals with two pathogenic alleles, either homozygotes (two copies of the same mutant allele) or compound heterozygotes (whereby each copy of a gene has a distinct mutant allele). Evidence: PCS. (PMID:28285122)
- Visual impairment (HP:0000505): Visual impairment (or vision impairment) is vision loss (of a person) to such a degree as to qualify as an additional support need through a significant limitation of visual capability resulting from either disease, trauma, or congenital or degenerative conditions that cannot be corrected by conventional means, such as refractive correction, medication, or surgery. Evidence: TAS. (OMIM:600627)
- Pes planus (HP:0001763): A foot where the longitudinal arch of the foot is in contact with the ground or floor when the individual is standing; or, in a patient lying supine, a foot where the arch is in contact with the surface of a flat board pressed against the sole of the foot by the examiner with a pressure similar to that expected from weight bearing; or, the height of the arch is reduced. Evidence: TAS. (OMIM:600627)
- Myopia (HP:0000545): An abnormality of refraction characterized by the ability to see objects nearby clearly, while objects in the distance appear blurry. Evidence: IEA. (OMIM:600627)
- Intellectual disability (HP:0001249): The term intellectual disability or intellectual developmental disorder is used to describe significantly sub-average intellectual and adaptive functioning based on clinical assessment and as measured by individually administered, appropriately normed, standardized and validated tests of intellectual functioning and adaptive behavior, with onset during the developmental period from infancy through adolescence. Evidence: PCS. Frequency: 0/1. (PMID:28285122)
- Hypertryptophanemia (HP:0500134): The concentration of tryptophan in the blood circulation is above the upper limit of normal. Evidence: PCS. Frequency: 1/1. Onset: Neonatal onset (HP:0003623). (PMID:28285122)
- Neonatal onset (HP:0003623): Onset of signs or symptoms of disease within the first 28 days of life. Evidence: PCS. Frequency: 1/1. (PMID:28285122)